- Mild intellectual disability (HP:0001256): Mild intellectual disability (ID) is defined as a type of ID characterized by mildly sub-average adaptive functioning and intellectual functioning, with an intelligence quotient (IQ) the range of 50-69. Evidence: TAS. Frequency: Frequent (HP:0040282). (ORPHA:401820)
- Global developmental delay (HP:0001263): A delay in the achievement of motor or mental milestones in the domains of development of a child, including motor skills, speech and language, cognitive skills, and social and emotional skills. This term should only be used to describe children younger than five years of age. Evidence: TAS. Frequency: Frequent (HP:0040282). (ORPHA:401820)
- Agenesis of corpus callosum (HP:0001274): Absence of the corpus callosum as a result of the failure of the corpus callosum to develop, which can be the result of a failure in any one of the multiple steps of callosal development including cellular proliferation and migration, axonal growth or glial patterning at the midline. Evidence: TAS. Frequency: Frequent (HP:0040282). (ORPHA:401820)
- Gait disturbance (HP:0001288): The term gait disturbance can refer to any disruption of the ability to walk. Evidence: TAS. Frequency: Frequent (HP:0040282). (ORPHA:401820)
- Hyperreflexia (HP:0001347): Hyperreflexia is the presence of hyperactive stretch reflexes of the muscles. Evidence: TAS. Frequency: Frequent (HP:0040282). (ORPHA:401820)
- Lower limb spasticity (HP:0002061): Spasticity (velocity-dependent increase in tonic stretch reflexes with increased muscle tone and hyperexcitable tendon reflexes) in the muscles of the lower limbs, hips, and pelvis. Evidence: TAS. Frequency: Frequent (HP:0040282). (ORPHA:401820)
- Spastic gait (HP:0002064): Spasticity is manifested by increased stretch reflex which is intensified with movement velocity. This results in excessive and inappropriate muscle activation which can contribute to muscle hypertonia. Spastic gait is characterized by manifestations such as muscle hypertonia, stiff knee, and circumduction of the leg. Evidence: TAS. Frequency: Frequent (HP:0040282). (ORPHA:401820)
- Cerebral cortical atrophy (HP:0002120): Atrophy of the cortex of the cerebrum. Evidence: TAS. Frequency: Frequent (HP:0040282). (ORPHA:401820)
- Babinski sign (HP:0003487): Upturning of the big toe (and sometimes fanning of the other toes) in response to stimulation of the sole of the foot. If the Babinski sign is present it can indicate damage to the corticospinal tract. Evidence: TAS. Frequency: Frequent (HP:0040282). (ORPHA:401820)
- Generalized amyotrophy (HP:0003700): Generalized (diffuse, unlocalized) amyotrophy (muscle atrophy) affecting multiple muscles. Evidence: TAS. Frequency: Frequent (HP:0040282). (ORPHA:401820)
- Aplasia/Hypoplasia of the cerebellar vermis (HP:0006817): Absence or underdevelopment of the vermis of cerebellum. Evidence: TAS. Frequency: Frequent (HP:0040282). (ORPHA:401820)
- Progressive spastic paraplegia (HP:0007020). Evidence: TAS. Frequency: Frequent (HP:0040282). (ORPHA:401820)
- Abnormal myelination (HP:0012447): Any anomaly in the process by which myelin sheaths are formed and maintained around neurons. Evidence: TAS. Frequency: Frequent (HP:0040282). (ORPHA:401820)
- Abnormality of movement (HP:0100022): An abnormality of movement with a neurological basis characterized by changes in coordination and speed of voluntary movements. Evidence: TAS. Frequency: Frequent (HP:0040282). (ORPHA:401820)
- Limb tremor (HP:0200085). Evidence: TAS. Frequency: Frequent (HP:0040282). (ORPHA:401820)
These phenotypes are associated with the disease Autosomal recessive spastic paraplegia type 67 (ORPHA:401820).